- Sensorineural hearing impairment (HP:0000407): A type of hearing impairment in one or both ears related to an abnormal functionality of the cochlear nerve. Evidence: TAS. (OMIM:610419)
- Infantile onset (HP:0003593): Onset of signs or symptoms of disease between 28 days to one year of life. Evidence: TAS. (OMIM:610419)
- Autosomal recessive inheritance (HP:0000007): A mode of inheritance that is observed for traits related to a gene encoded on one of the autosomes (i.e., the human chromosomes 1-22) in which a trait manifests in individuals with two pathogenic alleles, either homozygotes (two copies of the same mutant allele) or compound heterozygotes (whereby each copy of a gene has a distinct mutant allele). Evidence: TAS. (OMIM:610419)
These phenotypes are associated with the disease autosomal recessive nonsyndromic hearing loss 68 (OMIM:610419).